Phenotypes associated with the disease lymphangioleiomyomatosis (OMIM:606690):
- Typified by somatic mosaicism (HP:0001442): Description of conditions in which affected individuals typically display somatic mosaicism, i.e., genetically distinct populations of somatic cells in a given organism caused by DNA mutations, epigenetic alterations of DNA, chromosomal abnormalities or the spontaneous reversion of inherited mutations. In many conditions typified by somatic mosaicism, constitutive mutation is lethal and cases are exclusively or predominantly mosaic. Evidence: TAS. (OMIM:606690)
- Pulmonary lymphangiomyomatosis (HP:0012798): Infiltration of smooth muscle-like cells in lymph vessels as well as the lung (pleura, alveolar septa, bronchi, pulmonary vessels and lymphatics as well as lymph nodes, especially in posterior mediastinum and retroperitoneum). Focal emphysema can develop because of airway narrowing, and the thoracic duct may be obliterated. Pulmonary lymphangiomyomatosis may lead to multiple small cysts with a hamartomatous proliferation of smooth muscle in their walls. Evidence: IEA. (OMIM:606690)